- Hypermelanotic macule (HP:0001034): A hyperpigmented circumscribed area of change in normal skin color without elevation or depression of any size. Evidence: IEA. (OMIM:151001)
- Autosomal dominant inheritance (HP:0000006): A mode of inheritance that is observed for traits related to a gene encoded on one of the autosomes (i.e., the human chromosomes 1-22) in which a trait manifests in heterozygotes. In the context of medical genetics, an autosomal dominant disorder is caused when a single copy of the mutant allele is present. Males and females are affected equally, and can both transmit the disorder with a risk of 50% for each child of inheriting the mutant allele. Evidence: IEA. (OMIM:151001)
These phenotypes are associated with the disease familial generalized lentiginosis (OMIM:151001).